- Autosomal recessive inheritance (HP:0000007): A mode of inheritance that is observed for traits related to a gene encoded on one of the autosomes (i.e., the human chromosomes 1-22) in which a trait manifests in individuals with two pathogenic alleles, either homozygotes (two copies of the same mutant allele) or compound heterozygotes (whereby each copy of a gene has a distinct mutant allele). Evidence: PCS. (PMID:19888295)
- Prelingual sensorineural hearing impairment (HP:0000399): A form of sensorineural deafness with either congenital onset or infantile onset, i.e., before the acquisition of speech. Evidence: PCS. Onset: Congenital onset (HP:0003577). (PMID:19888295)
These phenotypes are associated with the disease autosomal recessive nonsyndromic hearing loss 85 (OMIM:613392).